- Foot polydactyly (HP:0001829): A kind of polydactyly characterized by the presence of a supernumerary toe or toes. Evidence: TAS. Frequency: Very frequent (HP:0040281). (ORPHA:2155)
- Aganglionic megacolon (HP:0002251): An abnormality resulting from a lack of intestinal ganglion cells (i.e., an aganglionic section of bowel) that results in bowel obstruction with enlargement of the colon. Evidence: TAS. Frequency: Very frequent (HP:0040281). (ORPHA:2155)
- Renal agenesis (HP:0000104): Agenesis, that is, failure of the kidney to develop during embryogenesis and development. Evidence: TAS. Frequency: Frequent (HP:0040282). (ORPHA:2155)
- Hypertelorism (HP:0000316): Interpupillary distance more than 2 SD above the mean (alternatively, the appearance of an increased interpupillary distance or widely spaced eyes). Evidence: TAS. Frequency: Frequent (HP:0040282). (ORPHA:2155)
- Sensorineural hearing impairment (HP:0000407): A type of hearing impairment in one or both ears related to an abnormal functionality of the cochlear nerve. Evidence: TAS. Frequency: Frequent (HP:0040282). (ORPHA:2155)
- Postaxial hand polydactyly (HP:0001162): Supernumerary digits located at the ulnar side of the hand (that is, on the side with the fifth finger). Evidence: TAS. Frequency: Frequent (HP:0040282). (ORPHA:2155)
- Intellectual disability (HP:0001249): The term intellectual disability or intellectual developmental disorder is used to describe significantly sub-average intellectual and adaptive functioning based on clinical assessment and as measured by individually administered, appropriately normed, standardized and validated tests of intellectual functioning and adaptive behavior, with onset during the developmental period from infancy through adolescence. Evidence: TAS. Frequency: Frequent (HP:0040282). (ORPHA:2155)
These phenotypes are associated with the disease Hirschsprung disease-deafness-polydactyly syndrome (ORPHA:2155).